Phenotypes associated with the disease gelatinous drop-like corneal dystrophy (OMIM:204870):
- Corneal foreign body sensation (HP:0034804): A perception that an object is in contact with the eye. Evidence: PCS. (PMID:10192395)
- Childhood onset (HP:0011463): Onset of disease at the age of between 1 and 5 years. Evidence: PCS. (PMID:10192395)
- Corneal dystrophy (HP:0001131): The term corneal dystrophy embraces a heterogenous group of bilateral genetically determined non-inflammatory corneal diseases that are restricted to the cornea. Evidence: PCS. Onset: Childhood onset (HP:0011463). (PMID:10192395)
- Photophobia (HP:0000613): Excessive sensitivity to light with the sensation of discomfort or pain in the eyes due to exposure to bright light. Evidence: PCS. Onset: Childhood onset (HP:0011463). (PMID:10192395)
- Autosomal recessive inheritance (HP:0000007): A mode of inheritance that is observed for traits related to a gene encoded on one of the autosomes (i.e., the human chromosomes 1-22) in which a trait manifests in individuals with two pathogenic alleles, either homozygotes (two copies of the same mutant allele) or compound heterozygotes (whereby each copy of a gene has a distinct mutant allele). Evidence: PCS. (PMID:10192395)
- Reduced visual acuity (HP:0007663). Evidence: PCS. Onset: Young adult onset (HP:0011462). (PMID:10192395)
- Visual impairment (HP:0000505): Visual impairment (or vision impairment) is vision loss (of a person) to such a degree as to qualify as an additional support need through a significant limitation of visual capability resulting from either disease, trauma, or congenital or degenerative conditions that cannot be corrected by conventional means, such as refractive correction, medication, or surgery. Evidence: PCS. Onset: Young adult onset (HP:0011462). (PMID:10192395)
- Blurred vision (HP:0000622): Lack of sharpness of vision resulting in the inability to see fine detail. Evidence: PCS. Onset: Childhood onset (HP:0011463). (PMID:10192395)